- Adult onset (HP:0003581): Onset of disease manifestations in adulthood, defined here as at the age of 16 years or later. Evidence: PCS. Frequency: 2/2. (PMID:20810651)
- Autosomal dominant inheritance (HP:0000006): A mode of inheritance that is observed for traits related to a gene encoded on one of the autosomes (i.e., the human chromosomes 1-22) in which a trait manifests in heterozygotes. In the context of medical genetics, an autosomal dominant disorder is caused when a single copy of the mutant allele is present. Males and females are affected equally, and can both transmit the disorder with a risk of 50% for each child of inheriting the mutant allele. Evidence: PCS. (PMID:20810651)
- Gout (HP:0001997): Recurrent attacks of acute inflammatory arthritis of a joint or set of joints caused by elevated levels of uric acid in the blood which crystallize and are deposited in joints, tendons, and surrounding tissues. Evidence: PCS. Frequency: 2/2. (PMID:20810651)
- Hyperuricemia (HP:0002149): The concentration of uric acid in the blood circulation is above the upper limit of normal. Evidence: PCS. Frequency: 2/2. (PMID:20810651)
These phenotypes are associated with the disease Gout susceptibility 4 (OMIM:612671).